Phenotypes associated with the disease nephrotic syndrome, type 6 (OMIM:614196):
- Stage 5 chronic kidney disease (HP:0003774): A degree of kidney failure severe enough to require dialysis or kidney transplantation for survival characterized by a severe reduction in glomerular filtration rate (less than 15 ml/min/1.73 m2) and other manifestations including increased serum creatinine. Evidence: PCS. Frequency: 1/5. (PMID:21722858)
- Juvenile onset (HP:0003621): Onset of signs or symptoms of disease between the age of 5 and 15 years. Evidence: PCS. Frequency: 5/5. (PMID:21722858)
- Nephrotic syndrome (HP:0000100): Nephrotic syndrome is a collection of findings resulting from glomerular dysfunction with an increase in glomerular capillary wall permeability associated with pronounced proteinuria. Nephrotic syndrome refers to the constellation of clinical findings that result from severe renal loss of protein, with Proteinuria and hypoalbuminemia, edema, and hyperlipidemia. Evidence: PCS. Frequency: 5/5. (PMID:21722858)
- Tubulointerstitial fibrosis (HP:0005576): A progressive detrimental connective tissue deposition (fibrosis) on the kidney parenchyma involving the tubules and interstitial tissue of the kidney. Tubulointerstitial injury in the kidney is complex, involving a number of independent and overlapping cellular and molecular pathways, with renal interstitial fibrosis and tubular atrophy (IF/TA) as the final common pathway. However, IF and TA are separable, as shown by the profound TA in renal artery stenosis, which characteristically has little or no fibrosis (or inflammation). For new annotations it is preferable to annotate to the specific HPO terms for Renal interstitial fibrosis and/or Renal tubular atrophy. Evidence: PCS. Frequency: 1/2. (PMID:21722858)
- Edema (HP:0000969): An abnormal accumulation of fluid beneath the skin, or in one or more cavities of the body. Evidence: PCS. Frequency: 5/5. (PMID:21722858)
- Focal segmental glomerulosclerosis (HP:0000097): Segmental accumulation of scar tissue in individual (but not all) glomeruli. Evidence: PCS. Frequency: 1/2. (PMID:21722858)
- Hypoalbuminemia (HP:0003073): The concentration of albumin in the blood circulation is below the lower limit of normal. Evidence: PCS. Frequency: 5/5. (PMID:21722858)
- Autosomal recessive inheritance (HP:0000007): A mode of inheritance that is observed for traits related to a gene encoded on one of the autosomes (i.e., the human chromosomes 1-22) in which a trait manifests in individuals with two pathogenic alleles, either homozygotes (two copies of the same mutant allele) or compound heterozygotes (whereby each copy of a gene has a distinct mutant allele). Evidence: PCS. (PMID:21722858)
- Proteinuria (HP:0000093): Increased levels of protein in the urine. Evidence: PCS. Frequency: 5/5. (PMID:21722858)
- Minimal change glomerulonephritis (HP:0012579): The presence of minimal changes visible by light microscopy but flattened and fused podocyte foot processes on electron microscopy in a person with nephrotic range proteinuria. Evidence: PCS. Frequency: 1/2. (PMID:21722858)